Phenotypes associated with the disease Trichodysplasia-xeroderma syndrome (ORPHA:3361):
- Dry skin (HP:0000958): Skin characterized by the lack of natural or normal moisture. Evidence: TAS. Frequency: Very frequent (HP:0040281). (ORPHA:3361)
- Coarse hair (HP:0002208): Hair shafts are rough in texture. Evidence: TAS. Frequency: Very frequent (HP:0040281). (ORPHA:3361)
- Sparse scalp hair (HP:0002209): Decreased number of hairs per unit area of skin of the scalp. Evidence: TAS. Frequency: Very frequent (HP:0040281). (ORPHA:3361)
- Brittle hair (HP:0002299): Fragile, easily breakable hair, i.e., with reduced tensile strength. Evidence: TAS. Frequency: Very frequent (HP:0040281). (ORPHA:3361)
- Trichodysplasia (HP:0002552): Developmental dysplasia of the hair. Evidence: TAS. Frequency: Very frequent (HP:0040281). (ORPHA:3361)
- Pili torti (HP:0003777): Pili (from Latin pilus, hair) torti (from Latin tortus, twisted) refers to short and brittle hairs that appear flattened and twisted when viewed through a microscope. Evidence: TAS. Frequency: Very frequent (HP:0040281). (ORPHA:3361)
- Trichorrhexis nodosa (HP:0009886): Trichorrhexis nodosa is the formation of nodes along the hair shaft through which breakage readily occurs. It is thus a focal defect in the hair fiber that is characterized by thickening or weak points (nodes) that cause the hair to break off easily. The result is defective, abnormally fragile hair. Evidence: TAS. Frequency: Very frequent (HP:0040281). (ORPHA:3361)
- Sparse eyebrow (HP:0045075): Decreased density/number of eyebrow hairs. Evidence: TAS. Frequency: Very frequent (HP:0040281). (ORPHA:3361)
- Alopecia (HP:0001596): A noncongenital process of hair loss, which may progress to partial or complete baldness. Evidence: TAS. Frequency: Frequent (HP:0040282). (ORPHA:3361)
- Sparse body hair (HP:0002231): Sparseness of the body hair. Evidence: TAS. Frequency: Frequent (HP:0040282). (ORPHA:3361)